- Ectopia cordis (HP:0001683): Congenital malformation of the ventral wall with partial or total evisceration of the heart outside the thoracic cavity and through the defect in the ventral wall. Evidence: IEA. (OMIM:217100)
- Cleft palate (HP:0000175): Cleft palate is a developmental defect of the palate resulting from a failure of fusion of the palatine processes and manifesting as a separation of the roof of the mouth (soft and hard palate). Evidence: IEA. (OMIM:217100)
- Talipes equinovarus (HP:0001762): Talipes equinovarus (also called clubfoot) typically has four main components: inversion and adduction of the forefoot; inversion of the heel and hindfoot; equinus (limitation of extension) of the ankle and subtalar joint; and internal rotation of the leg. Evidence: IEA. (OMIM:217100)
- Scoliosis (HP:0002650): The presence of an abnormal lateral curvature of the spine. Evidence: IEA. (OMIM:217100)
- Abnormal lung lobation (HP:0002101): A developmental defect in the formation of pulmonary lobes. Evidence: IEA. (OMIM:217100)
- Hand polydactyly (HP:0001161): A kind of polydactyly characterized by the presence of a supernumerary finger or fingers. Evidence: IEA. (OMIM:217100)
- Encephalocele (HP:0002084): A neural tube defect characterized by sac-like protrusions of the brain and the membranes that cover it through openings in the skull. Evidence: IEA. (OMIM:217100)
- Bladder exstrophy (HP:0002836): Eversion of the posterior bladder wall through the congenitally absent lower anterior abdominal wall and anterior bladder wall. Evidence: IEA. (OMIM:217100)
- Abnormal rib cage morphology (HP:0001547): A morphological anomaly of the rib cage. Evidence: IEA. (OMIM:217100)
- Omphalocele (HP:0001539): A midline anterior incomplete closure of the abdominal wall in which there is herniation of the abdominal viscera into the base of the abdominal cord. Evidence: IEA. (OMIM:217100)
- Eyelid coloboma (HP:0000625): A short discontinuity of the margin of the lower or upper eyelid. Evidence: IEA. (OMIM:217100)
- Syndactyly (HP:0001159): Webbing or fusion of the fingers or toes, involving soft parts only or including bone structure. Bony fusions are referred to as "bony" syndactyly if the fusion occurs in a radio-ulnar axis. Fusions of bones of the fingers or toes in a proximo-distal axis are referred to as "symphalangism". Evidence: IEA. (OMIM:217100)
- Sporadic (HP:0003745): Cases of the disease in question occur without a previous family history, i.e., as isolated cases without being transmitted from a parent and without other siblings being affected. Evidence: IEA. (OMIM:217100)
- Gastroschisis (HP:0001543): A type of congenital ventral incomplete closure of the abdominal wall in which the intestines and sometimes other organs extend freely into the amniotic fluid space through a small opening in the abdomen, usually to the right of the umbilicus. Evidence: IEA. (OMIM:217100)
- Cleft upper lip (HP:0000204): A gap or groove in the upper lip. This is a congenital defect resulting from nonfusion of tissues of the lip during embryonal development. Evidence: IEA. (OMIM:217100)
- Tessier cleft (HP:0002006): A congenital malformation with a cleft (gap or opening) in the face. Evidence: TAS. (OMIM:217100)
These phenotypes are associated with the disease amniotic band syndrome (OMIM:217100).